Phenotypes associated with the disease Loeffler endocarditis (ORPHA:75566):
- Restrictive cardiomyopathy (HP:0001723): Restrictive left ventricular physiology is characterized by a pattern of ventricular filling in which increased stiffness of the myocardium causes ventricular pressure to rise precipitously with only small increases in volume, defined as restrictive ventricular physiology in the presence of normal or reduced diastolic volumes (of one or both ventricles), normal or reduced systolic volumes, and normal ventricular wall thickness. Evidence: TAS. Frequency: Very frequent (HP:0040281). (ORPHA:75566)
- Increased total eosinophil count (HP:0001880): Increased count of eosinophils in the blood. Evidence: TAS. Frequency: Very frequent (HP:0040281). (ORPHA:75566)
- Abnormal thrombosis (HP:0001977): Venous or arterial thrombosis (formation of blood clots) of spontaneous nature and which cannot be fully explained by acquired risk (e.g. atherosclerosis). Evidence: TAS. Frequency: Very frequent (HP:0040281). (ORPHA:75566)
- Myocardial eosinophilic infiltration (HP:0031323): An increase in the number of eosinophils in myocardial tissue. Evidence: TAS. Frequency: Very frequent (HP:0040281). (ORPHA:75566)
- Congestive heart failure (HP:0001635): The presence of an abnormality of cardiac function that is responsible for the failure of the heart to pump blood at a rate that is commensurate with the needs of the tissues or a state in which abnormally elevated filling pressures are required for the heart to do so. Heart failure is frequently related to a defect in myocardial contraction. Evidence: TAS. Frequency: Frequent (HP:0040282). (ORPHA:75566)
- Abnormal heart valve morphology (HP:0001654): Any structural abnormality of a cardiac valve. Evidence: TAS. Frequency: Frequent (HP:0040282). (ORPHA:75566)
- Left ventricular hypertrophy (HP:0001712): Enlargement or increased size of the heart left ventricle. Evidence: TAS. Frequency: Frequent (HP:0040282). (ORPHA:75566)
- Weight loss (HP:0001824): Reduction of total body weight. Evidence: TAS. Frequency: Frequent (HP:0040282). (ORPHA:75566)
- Palpitations (HP:0001962): A sensation that the heart is pounding or racing, which is a non-specific sign but may be a manifestation of arrhythmia. Evidence: TAS. Frequency: Frequent (HP:0040282). (ORPHA:75566)
- Dyspnea (HP:0002094): Difficult or labored breathing. Dyspnea is a subjective feeling only the patient can rate, e.g., on a Borg scale. Evidence: TAS. Frequency: Frequent (HP:0040282). (ORPHA:75566)
- Fatigue (HP:0012378): A subjective feeling of tiredness characterized by a lack of energy and motivation. Evidence: TAS. Frequency: Frequent (HP:0040282). (ORPHA:75566)
- Left ventricular diastolic dysfunction (HP:0025168): Abnormal function of the left ventricule during left ventricular relaxation and filling. Evidence: TAS. Frequency: Frequent (HP:0040282). (ORPHA:75566)
- Abnormal cardiomyocyte morphology (HP:0031331): Any structural anomaly of cardiomyocytes, which are terminally differentiated muscle cells in the heart that are interconnected end to end by gap junctions, which allows coordinated contraction of heart tissue. Evidence: TAS. Frequency: Frequent (HP:0040282). (ORPHA:75566)
- Chest pain (HP:0100749): An unpleasant sensation characterized by physical discomfort (such as pricking, throbbing, or aching) localized to the chest. Evidence: TAS. Frequency: Frequent (HP:0040282). (ORPHA:75566)
- Mitral regurgitation (HP:0001653): An abnormality of the mitral valve characterized by insufficiency or incompetence of the mitral valve resulting in retrograde leaking of blood through the mitral valve upon ventricular contraction. Evidence: TAS. Frequency: Occasional (HP:0040283). (ORPHA:75566)
- Myocardial fibrosis (HP:0001685): Myocardial fibrosis is characterized by dysregulated collagen turnover (increased synthesis predominates over unchanged or decreased degradation) and excessive diffuse collagen accumulation in the interstitial and perivascular spaces as well as by phenotypically transformed fibroblasts, termed myofibroblasts. Evidence: TAS. Frequency: Occasional (HP:0040283). (ORPHA:75566)
- Endocardial fibrosis (HP:0006685): The presence of excessive connective tissue in the endocardium. Evidence: TAS. Frequency: Occasional (HP:0040283). (ORPHA:75566)
- T-wave inversion (HP:0010872): An inversion of the T-wave (which is normally positive). Evidence: TAS. Frequency: Occasional (HP:0040283). (ORPHA:75566)
- Arrhythmia (HP:0011675): Any cardiac rhythm other than the normal sinus rhythm. Such a rhythm may be either of sinus or ectopic origin and either regular or irregular. An arrhythmia may be due to a disturbance in impulse formation or conduction or both. Evidence: TAS. Frequency: Occasional (HP:0040283). (ORPHA:75566)
- Complete right bundle branch block (HP:0011712): A conduction block of the right branch of the bundle of His. This manifests as a prolongation of the QRS complex (greater than 0.12 s) with delayed activation of the right ventricle and terminal delay on the EKG. Evidence: TAS. Frequency: Occasional (HP:0040283). (ORPHA:75566)
- Cough (HP:0012735): A sudden, audible expulsion of air from the lungs through a partially closed glottis, preceded by inhalation. Evidence: TAS. Frequency: Occasional (HP:0040283). (ORPHA:75566)
- Abnormal morphology of the chordae tendinae of the mitral valve (HP:0025523): A structural anomaly of the chordae tendinae of the mitral valve, whose main function is to transmit the contraction and relaxation of the papillary muscles during the cardiac cycle, thus ensuring the closing of the leaflets of the mitral valve. Evidence: TAS. Frequency: Occasional (HP:0040283). (ORPHA:75566)
- Left atrial enlargement (HP:0031295): Increase in size of the left atrium. Evidence: TAS. Frequency: Occasional (HP:0040283). (ORPHA:75566)
- Abnormal tricuspid chordae tendinae morphology (HP:0031442): Any structural anomaly of the chordae tendinae of the tricuspid valve. The chordae tendineae connect the papillary muscles to the tricuspid valve. Evidence: TAS. Frequency: Occasional (HP:0040283). (ORPHA:75566)
- Aortic valve stenosis (HP:0001650): The presence of a stenosis (narrowing) of the aortic valve. Evidence: TAS. Frequency: Very rare (HP:0040284). (ORPHA:75566)
- Aortic regurgitation (HP:0001659): An insufficiency of the aortic valve, leading to regurgitation (backward flow) of blood from the aorta into the left ventricle. Evidence: TAS. Frequency: Very rare (HP:0040284). (ORPHA:75566)
- Pericarditis (HP:0001701): Inflammation of the sac-like covering around the heart (pericardium). Evidence: TAS. Frequency: Very rare (HP:0040284). (ORPHA:75566)